Phenotypes associated with the disease Familial hyperaldosteronism type II (ORPHA:404):
- Hypertension (HP:0000822): The presence of chronic increased pressure in the systemic arterial system. Evidence: TAS. Frequency: Obligate (HP:0040280). (ORPHA:404)
- Glucocortocoid-insensitive primary hyperaldosteronism (HP:0011740): A form of primary hyperaldosteronism in which the overproduction of aldosterone cannot be suppressed by the administration of dexamethasone or similar glucocorticoids. Evidence: TAS. Frequency: Very frequent (HP:0040281). (ORPHA:404)
- Abnormal circulating renin concentration (HP:0040084): A deviation from the normal concentration of renin in the blood, a central hormone in the control of blood pressure and various other physiological functions. Evidence: TAS. Frequency: Very frequent (HP:0040281). (ORPHA:404)
- Secretory adrenocortical adenoma (HP:0011746): An hormonally active adrenocortical adenoma, that is, an adenoma that secretes excessive amounts of adrenal hormones. Evidence: TAS. Frequency: Frequent (HP:0040282). (ORPHA:404)
- Tinnitus (HP:0000360): Tinnitus is an auditory perception that can be described as the experience of sound, in the ear or in the head, in the absence of external acoustic stimulation. Evidence: TAS. Frequency: Occasional (HP:0040283). (ORPHA:404)
- Epistaxis (HP:0000421): Epistaxis, or nosebleed, refers to a hemorrhage localized in the nose. Evidence: TAS. Frequency: Occasional (HP:0040283). (ORPHA:404)
- Muscle weakness (HP:0001324): Reduced strength of muscles. Evidence: TAS. Frequency: Occasional (HP:0040283). (ORPHA:404)
- Nausea (HP:0002018): A sensation of unease in the stomach together with an urge to vomit. Evidence: TAS. Frequency: Occasional (HP:0040283). (ORPHA:404)
- Intracranial hemorrhage (HP:0002170): Hemorrhage occurring within the skull. Evidence: TAS. Frequency: Occasional (HP:0040283). (ORPHA:404)
- Headache (HP:0002315): Cephalgia, or pain sensed in various parts of the head, not confined to the area of distribution of any nerve. Evidence: TAS. Frequency: Occasional (HP:0040283). (ORPHA:404)
- Hypokalemia (HP:0002900): The concentration of potassium(1+) in the blood circulation is below the lower limit of normal. Evidence: TAS. Frequency: Occasional (HP:0040283). (ORPHA:404)
- Adrenal hyperplasia (HP:0008221): Enlargement of the adrenal gland. Evidence: TAS. Frequency: Occasional (HP:0040283). (ORPHA:404)
- Metabolic alkalosis (HP:0200114): Metabolic alkalosis is defined as a disease state where the pH is elevated to greater than 7.45 secondary to some metabolic process. Evidence: TAS. Frequency: Occasional (HP:0040283). (ORPHA:404)
Not associated with this disease:
- Dexamethasone-suppressible primary hyperaldosteronism (HP:0011739): A form of primary hyperaldosteronism in which the overproduction of aldosterone can be suppressed by the administration of dexamethasone. Evidence: TAS. (ORPHA:404)